Phenotypes associated with the disease atrial septal defect 8 (OMIM:614433):
- Anomalous pulmonary venous return (HP:0010772): A developmental defect characterized by abnormal connection of one or more pulmonary veins to the superior or inferior vena cava, the right atrium, or the coronary sinus, resulting in a left-to-right shunt of oxygenated blood. Evidence: PCS. Frequency: 1/2. (PMID:16287139)
- Atrial septal defect (HP:0001631): Atrial septal defect (ASD) is a congenital abnormality of the interatrial septum that enables blood flow between the left and right atria via the interatrial septum. Evidence: PCS. Frequency: 2/2. (PMID:16287139)
- Autosomal dominant inheritance (HP:0000006): A mode of inheritance that is observed for traits related to a gene encoded on one of the autosomes (i.e., the human chromosomes 1-22) in which a trait manifests in heterozygotes. In the context of medical genetics, an autosomal dominant disorder is caused when a single copy of the mutant allele is present. Males and females are affected equally, and can both transmit the disorder with a risk of 50% for each child of inheriting the mutant allele. Evidence: PCS. (PMID:16287139)